- Bilateral tonic-clonic seizure (HP:0002069): A bilateral tonic-clonic seizure is a seizure defined by a tonic (bilateral increased tone, lasting seconds to minutes) and then a clonic (bilateral sustained rhythmic jerking) phase. Evidence: IEA. (OMIM:609253)
- Febrile seizure (within the age range of 3 months to 6 years) (HP:0002373): A febrile seizure is any type of seizure (most often a generalized tonic-clonic seizure) occurring with fever (at least 38 degrees Celsius) but in the absence of central nervous system infection, severe metabolic disturbance or other alternative precipitant in children between the ages of 3 months and 6 years. Evidence: TAS. Frequency: 20/20. (OMIM:609253)
- Childhood onset (HP:0011463): Onset of disease at the age of between 1 and 5 years. Evidence: IEA. (OMIM:609253)
- Atonic seizure (HP:0010819): Atonic seizure is a type of motor seizure characterized by a sudden loss or diminution of muscle tone without apparent preceding myoclonic or tonic event lasting about 1 to 2 seconds, involving head, trunk, jaw, or limb musculature. Evidence: IEA. (OMIM:609253)
- Generalized tonic seizure (HP:0010818): A generalized tonic seizure is a type of generalized motor seizure characterized by bilateral limb stiffening or elevation, often with neck stiffening without a subsequent clonic phase. The tonic activity can be a sustained abnormal posture, either in extension or flexion, sometimes accompanied by tremor of the extremities. Evidence: IEA. (OMIM:609253)
- Autosomal dominant inheritance (HP:0000006): A mode of inheritance that is observed for traits related to a gene encoded on one of the autosomes (i.e., the human chromosomes 1-22) in which a trait manifests in heterozygotes. In the context of medical genetics, an autosomal dominant disorder is caused when a single copy of the mutant allele is present. Males and females are affected equally, and can both transmit the disorder with a risk of 50% for each child of inheriting the mutant allele. Evidence: IEA. (OMIM:609253)
These phenotypes are associated with the disease febrile seizures, familial, 6 (OMIM:609253).